Phenotypes associated with the disease Pseudouridinuria and mental defect (OMIM:264500):
- Abnormality of metabolism/homeostasis (HP:0001939). Evidence: IEA. (OMIM:264500)
- Autosomal recessive inheritance (HP:0000007): A mode of inheritance that is observed for traits related to a gene encoded on one of the autosomes (i.e., the human chromosomes 1-22) in which a trait manifests in individuals with two pathogenic alleles, either homozygotes (two copies of the same mutant allele) or compound heterozygotes (whereby each copy of a gene has a distinct mutant allele). Evidence: IEA. (OMIM:264500)
- Intellectual disability (HP:0001249): The term intellectual disability or intellectual developmental disorder is used to describe significantly sub-average intellectual and adaptive functioning based on clinical assessment and as measured by individually administered, appropriately normed, standardized and validated tests of intellectual functioning and adaptive behavior, with onset during the developmental period from infancy through adolescence. Evidence: IEA. (OMIM:264500)